Phenotypes associated with the disease growth delay due to insulin-like growth factor type 1 deficiency (OMIM:608747):
- Decreased body weight (HP:0004325): Abnormally low body weight. Evidence: PCS. Frequency: 1/1. (PMID:8857020)
- Congenital onset (HP:0003577): A phenotypic abnormality that is present at birth. Evidence: PCS. Frequency: 1/1. (PMID:8857020)
- Microcephaly (HP:0000252): Head circumference below 2 standard deviations below the mean for age and gender. Evidence: PCS. Frequency: 1/1. (PMID:8857020)
- Delayed skeletal maturation (HP:0002750): A decreased rate of skeletal maturation. Delayed skeletal maturation can be diagnosed on the basis of an estimation of the bone age from radiographs of specific bones in the human body. Evidence: PCS. Frequency: 1/1. (PMID:8857020)
- Short stature (HP:0004322): A height below that which is expected according to age and gender norms. Although there is no universally accepted definition of short stature, many refer to "short stature" as height more than 2 standard deviations below the mean for age and gender (or below the 3rd percentile for age and gender dependent norms). Evidence: PCS. Frequency: 1/1. (PMID:8857020)
- Decreased circulating insulin-like growth factor 1 concentration (HP:0030353): The concentration of insulin-like growth factor 1 (IGF1) in the blood circulation is below the lower limit of normal. Evidence: PCS. Frequency: 1/1. (PMID:8857020)
- Motor delay (HP:0001270): A type of Developmental delay characterized by a delay in acquiring motor skills. Evidence: PCS. Frequency: 1/1. (PMID:8857020)
- Sensorineural hearing impairment (HP:0000407): A type of hearing impairment in one or both ears related to an abnormal functionality of the cochlear nerve. Evidence: PCS. Frequency: 1/1. (PMID:8857020)
- Osteopenia (HP:0000938): Osteopenia is a term to define bone density that is not normal but also not as low as osteoporosis. By definition from the World Health Organization osteopenia is defined by bone densitometry as a T score -1 to -2.5. Evidence: PCS. Frequency: 1/1. (PMID:8857020)
- Ptosis (HP:0000508): The upper eyelid margin is positioned 3 mm or more lower than usual and covers the superior portion of the iris (objective); or, the upper lid margin obscures at least part of the pupil (subjective). Evidence: PCS. Frequency: 1/1. (PMID:8857020)
- Autosomal recessive inheritance (HP:0000007): A mode of inheritance that is observed for traits related to a gene encoded on one of the autosomes (i.e., the human chromosomes 1-22) in which a trait manifests in individuals with two pathogenic alleles, either homozygotes (two copies of the same mutant allele) or compound heterozygotes (whereby each copy of a gene has a distinct mutant allele). Evidence: PCS. (PMID:8857020)
- Short attention span (HP:0000736): Reduced attention span characterized by distractibility and impulsivity. Evidence: PCS. Frequency: 1/1. (PMID:8857020)
- Postnatal growth retardation (HP:0008897): Slow or limited growth after birth. Evidence: PCS. Frequency: 1/1. (PMID:8857020)
- Elevated circulating growth hormone concentration (HP:0000845): Acromegaly is a condition resulting from overproduction of growth hormone by the pituitary gland in persons with closed epiphyses, and consists chiefly in the enlargement of the distal parts of the body. The circumference of the skull increases, the nose becomes broad, the tongue becomes enlarged, the facial features become coarsened, the mandible grows excessively, and the teeth become separated. The fingers and toes grow chiefly in thickness. Evidence: PCS. Frequency: 1/1. (PMID:8857020)
- Clinodactyly of the 5th finger (HP:0004209): Clinodactyly refers to a bending or curvature of the fifth finger in the radial direction (i.e., towards the 4th finger). Evidence: PCS. Frequency: 1/1. (PMID:8857020)
- Hyperactivity (HP:0000752): Hyperactivity is a condition characterized by constant and unusually high levels of activity, even in situations where it is deemed inappropriate. Evidence: PCS. Frequency: 1/1. (PMID:8857020)
- Intrauterine growth retardation (HP:0001511): An abnormal restriction of fetal growth with fetal weight below the tenth percentile for gestational age. Evidence: PCS. Frequency: 1/1. (PMID:8857020)
- Intellectual disability (HP:0001249): The term intellectual disability or intellectual developmental disorder is used to describe significantly sub-average intellectual and adaptive functioning based on clinical assessment and as measured by individually administered, appropriately normed, standardized and validated tests of intellectual functioning and adaptive behavior, with onset during the developmental period from infancy through adolescence. Evidence: PCS. Frequency: 1/1. (PMID:8857020)
- Micrognathia (HP:0000347): Developmental hypoplasia of the mandible. Evidence: PCS. Frequency: 1/1. (PMID:8857020)